Phenotypes associated with the disease Developmental delay-language impairment-dopa responsive dystonia-parkinsonism syndrome due to 2q24 microdeletion (ORPHA:1617):
- Cleft palate (HP:0000175): Cleft palate is a developmental defect of the palate resulting from a failure of fusion of the palatine processes and manifesting as a separation of the roof of the mouth (soft and hard palate). Evidence: TAS. Frequency: Very frequent (HP:0040281). (ORPHA:1617)
- Short neck (HP:0000470): Diminished length of the neck. Evidence: TAS. Frequency: Very frequent (HP:0040281). (ORPHA:1617)
- Downslanted palpebral fissures (HP:0000494): The palpebral fissure inclination is more than two standard deviations below the mean. Evidence: TAS. Frequency: Very frequent (HP:0040281). (ORPHA:1617)
- Abnormality iris morphology (HP:0000525): An abnormality of the iris, which is the pigmented muscular tissue between the cornea and the lens, that is perforated by an opening called the pupil. Evidence: TAS. Frequency: Very frequent (HP:0040281). (ORPHA:1617)
- Atypical behavior (HP:0000708): Atypical behavior is an abnormality in a person's actions that can be controlled or modulated by the will of the individual. While abnormal behaviors can be difficult to control, they are distinct from other abnormal actions that cannot be affected by the individual's will. Evidence: TAS. Frequency: Very frequent (HP:0040281). (ORPHA:1617)
- Hand clenching (HP:0001188): An abnormal hand posture in which the hands are clenched to fists. All digits held completely flexed at the metacarpophalangeal and interphalangeal joints. In prenatal sonography of the fetal clenched hand, the index finger overlaps a clenched fist formed by the other digits. The proximal interphalangeal articulation of the index finger is flexed and ulnarly deviated, and the thumb is adducted. Evidence: TAS. Frequency: Very frequent (HP:0040281). (ORPHA:1617)
- Intellectual disability (HP:0001249): The term intellectual disability or intellectual developmental disorder is used to describe significantly sub-average intellectual and adaptive functioning based on clinical assessment and as measured by individually administered, appropriately normed, standardized and validated tests of intellectual functioning and adaptive behavior, with onset during the developmental period from infancy through adolescence. Evidence: TAS. Frequency: Very frequent (HP:0040281). (ORPHA:1617)
- Seizure (HP:0001250): A seizure is an intermittent abnormality of nervous system physiology characterized by a transient occurrence of signs and/or symptoms due to abnormal excessive or synchronous neuronal activity in the brain. Evidence: TAS. Frequency: Very frequent (HP:0040281). (ORPHA:1617)
- Global developmental delay (HP:0001263): A delay in the achievement of motor or mental milestones in the domains of development of a child, including motor skills, speech and language, cognitive skills, and social and emotional skills. This term should only be used to describe children younger than five years of age. Evidence: TAS. Frequency: Very frequent (HP:0040281). (ORPHA:1617)
- Neonatal hypotonia (HP:0001319): Muscular hypotonia (abnormally low muscle tone) manifesting in the neonatal period. Evidence: TAS. Frequency: Very frequent (HP:0040281). (ORPHA:1617)
- Failure to thrive (HP:0001508): Failure to thrive (FTT) refers to a child whose physical growth is substantially below the norm. Evidence: TAS. Frequency: Very frequent (HP:0040281). (ORPHA:1617)
- Growth delay (HP:0001510): A deficiency or slowing down of growth pre- and postnatally. Evidence: TAS. Frequency: Very frequent (HP:0040281). (ORPHA:1617)
- Small for gestational age (HP:0001518): Smaller than normal size according to sex and gestational age related norms, defined as a weight below the 10th percentile for the gestational age. Evidence: TAS. Frequency: Very frequent (HP:0040281). (ORPHA:1617)
- Toe syndactyly (HP:0001770): Webbing or fusion of the toes, involving soft parts only or including bone structure. Bony fusions are referred to as "bony" Syndactyly if the fusion occurs in a radio-ulnar axis. Fusions of bones of the toes in a proximo-distal axis are referred to as "Symphalangism". Evidence: TAS. Frequency: Very frequent (HP:0040281). (ORPHA:1617)
- Bullet-shaped distal phalanx of the hallux (HP:0010078): An abnormal morphology of the distal phalanx of the big toe, with a short and wide phalanx that tapers distally. Bullet-shaped phalanges lack the normal diaphyseal constriction. Evidence: TAS. Frequency: Very frequent (HP:0040281). (ORPHA:1617)
- Severe global developmental delay (HP:0011344): A severe delay in the achievement of motor or mental milestones in the domains of development of a child. Evidence: TAS. Frequency: Very frequent (HP:0040281). (ORPHA:1617)
- Camptodactyly of finger (HP:0100490): The distal interphalangeal joint and/or the proximal interphalangeal joint of the fingers cannot be extended to 180 degrees by either active or passive extension. Evidence: TAS. Frequency: Very frequent (HP:0040281). (ORPHA:1617)
- Long fingers (HP:0100807): The middle finger is more than 2 SD above the mean for newborns 27 to 41 weeks EGA or above the 97th centile for children from birth to 16 years of age AND the five digits retain their normal length proportions relative to each other (i.e., it is not the case that the middle finger is the only lengthened digit), or, Fingers that appear disproportionately long compared to the palm of the hand. Evidence: TAS. Frequency: Very frequent (HP:0040281). (ORPHA:1617)
- Abnormal oral frenulum morphology (HP:0000190): An abnormality of the lingual frenulum, that is of the small fold of mucous membrane that attaches the tongue to the floor of the mouth, or the presence of accessory frenula in the oral cavity. Evidence: TAS. Frequency: Frequent (HP:0040282). (ORPHA:1617)
- Small face (HP:0000274): A face that is short and narrow. Evidence: TAS. Frequency: Frequent (HP:0040282). (ORPHA:1617)
- Hypertelorism (HP:0000316): Interpupillary distance more than 2 SD above the mean (alternatively, the appearance of an increased interpupillary distance or widely spaced eyes). Evidence: TAS. Frequency: Frequent (HP:0040282). (ORPHA:1617)
- Short philtrum (HP:0000322): Distance between nasal base and midline upper lip vermilion border more than 2 SD below the mean. Alternatively, an apparently decreased distance between nasal base and midline upper lip vermilion border. Evidence: TAS. Frequency: Frequent (HP:0040282). (ORPHA:1617)
- Cataract (HP:0000518): A cataract is an opacity or clouding that develops in the crystalline lens of the eye or in its capsule. Evidence: TAS. Frequency: Frequent (HP:0040282). (ORPHA:1617)
- Microphthalmia (HP:0000568): A developmental anomaly characterized by abnormal smallness of one or both eyes. Evidence: TAS. Frequency: Frequent (HP:0040282). (ORPHA:1617)
- Coloboma (HP:0000589): A developmental defect characterized by a cleft of some portion of the eye or ocular adnexa. Evidence: TAS. Frequency: Frequent (HP:0040282). (ORPHA:1617)
- Autistic behavior (HP:0000729): Persistent deficits in social interaction and communication and interaction as well as a markedly restricted repertoire of activity and interest as well as repetitive patterns of behavior. Evidence: TAS. Frequency: Frequent (HP:0040282). (ORPHA:1617)
- Central apnea (HP:0002871): Apnea resulting from depression of the respiratory centers in the medulla oblongata. There is a lack of respiratory effort rather than obstruction of airflow. Evidence: TAS. Frequency: Occasional (HP:0040283). (ORPHA:1617)
- Posteriorly rotated ears (HP:0000358): A type of abnormal location of the ears in which the position of the ears is characterized by posterior rotation (the superior part of the ears is rotated towards the back of the head, and the inferior part of the ears towards the front). Evidence: TAS. Frequency: Very frequent (HP:0040281). (ORPHA:1617)